- Cerebral vasculitis (HP:0005318): Inflammation of the blood vessels within the brain. Evidence: TAS. Frequency: Very frequent (HP:0040281). (ORPHA:83601)
- Hypothyroidism (HP:0000821): Deficiency of thyroid hormone. Evidence: TAS. Frequency: Frequent (HP:0040282). (ORPHA:83601)
- Goiter (HP:0000853): An enlargement of the thyroid gland. Evidence: TAS. Frequency: Frequent (HP:0040282). (ORPHA:83601)
- Confusion (HP:0001289): Lack of clarity and coherence of thought, perception, understanding, or action. Evidence: TAS. Frequency: Frequent (HP:0040282). (ORPHA:83601)
- Abnormal cerebral white matter morphology (HP:0002500): An abnormality of the cerebral white matter. Evidence: TAS. Frequency: Frequent (HP:0040282). (ORPHA:83601)
- Hyponatremia (HP:0002902): The concentration of sodium in the blood circulation is below the lower limit of normal. Evidence: TAS. Frequency: Frequent (HP:0040282). (ORPHA:83601)
- Paralysis (HP:0003470): Paralysis of voluntary muscles means loss of contraction due to interruption of one or more motor pathways from the brain to the muscle fibers. Although the word paralysis is often used interchangeably to mean either complete or partial loss of muscle strength, it is preferable to use paralysis or plegia for complete or severe loss of muscle strength, and paresis for partial or slight loss. Motor paralysis results from deficits of the upper motor neurons (corticospinal, corticobulbar, or subcorticospinal). Motor paralysis is often accompanied by an impairment in the facility of movement. Evidence: TAS. Frequency: Frequent (HP:0040282). (ORPHA:83601)
- Psychosis (HP:0000709): A condition characterized by changes in personality and thought patterns, often accompanied by hallucinations and delusional beliefs, is known as psychosis. Evidence: TAS. Frequency: Occasional (HP:0040283). (ORPHA:83601)
- Depression (HP:0000716): Frequently experiencing feelings of being down, miserable, and/or hopeless; struggling to recover from these moods; having a pessimistic outlook on the future; feeling a pervasive sense of shame; having a low self-worth; experiencing thoughts of suicide and engaging in suicidal behavior. Evidence: TAS. Frequency: Occasional (HP:0040283). (ORPHA:83601)
- Anxiety (HP:0000739): Intense feelings of nervousness, tension, or panic often arise in response to interpersonal stresses. There is worry about the negative effects of past unpleasant experiences and future negative possibilities. Individuals may feel fearful, apprehensive, or threatened by uncertainty, and they may also have fears of falling apart or losing control. Evidence: TAS. Frequency: Occasional (HP:0040283). (ORPHA:83601)
- Thrombocytopenia (HP:0001873): A reduction in the number of circulating thrombocytes. Evidence: TAS. Frequency: Occasional (HP:0040283). (ORPHA:83601)
- Fever (HP:0001945): Body temperature elevated above the normal range. Evidence: TAS. Frequency: Occasional (HP:0040283). (ORPHA:83601)
- Increased total leukocyte count (HP:0001974): An abnormal increase in the number of leukocytes in the blood. Evidence: TAS. Frequency: Occasional (HP:0040283). (ORPHA:83601)
- Nausea and vomiting (HP:0002017): Nausea is a commonly encountered symptom that has been defined as an unpleasant painless subjective feeling that one will imminently vomit. Vomiting has been defined as the forceful expulsion of the contents of the stomach, duodenum, or jejunum through the oral cavity. While nausea and vomiting are often thought to exist on a temporal continuum, this is not always the case. There are situations when severe nausea may be present without emesis and less frequently, when emesis may be present without preceding nausea. Evidence: TAS. Frequency: Occasional (HP:0040283). (ORPHA:83601)
- Status epilepticus (HP:0002133): Status epilepticus is a type of prolonged seizure resulting either from the failure of the mechanisms responsible for seizure termination or from the initiation of mechanisms which lead to abnormally prolonged seizures (after time point t1). It is a condition that can have long-term consequences (after time point t2), including neuronal death, neuronal injury, and alteration of neuronal networks, depending on the type and duration of seizures. Evidence: TAS. Frequency: Occasional (HP:0040283). (ORPHA:83601)
- Generalized-onset seizure (HP:0002197): A generalized-onset seizure is a type of seizure originating at some point within, and rapidly engaging, bilaterally distributed networks. The networks may include cortical and subcortical structures but not necessarily the entire cortex. Evidence: TAS. Frequency: Occasional (HP:0040283). (ORPHA:83601)
- Headache (HP:0002315): Cephalgia, or pain sensed in various parts of the head, not confined to the area of distribution of any nerve. Evidence: TAS. Frequency: Occasional (HP:0040283). (ORPHA:83601)
- Immunodeficiency (HP:0002721): Failure of the immune system to protect the body adequately from infection, due to the absence or insufficiency of some component process or substance. Evidence: TAS. Frequency: Occasional (HP:0040283). (ORPHA:83601)
- Focal-onset seizure (HP:0007359): A focal-onset seizure is a type of seizure originating within networks limited to one hemisphere. They may be discretely localized or more widely distributed, and may originate in subcortical structures. Evidence: TAS. Frequency: Occasional (HP:0040283). (ORPHA:83601)
- Anterior open-bite malocclusion (HP:0009102): Anterior open bite is a malocclusion characterized by a gap between the anterior teeth (incisors), that is, by a deficiency in the normal vertical overlap between antagonist incisal edges when the posterior teeth are in occlusion. Evidence: TAS. Frequency: Occasional (HP:0040283). (ORPHA:83601)
- Abnormal autonomic nervous system physiology (HP:0012332): A functional abnormality of the autonomic nervous system. Evidence: TAS. Frequency: Occasional (HP:0040283). (ORPHA:83601)
- Limited neck flexion (HP:0005991): Reduced ability to lower the chin towards the chest by bending the neck. Evidence: TAS. Frequency: Very rare (HP:0040284). (ORPHA:83601)
- Acute encephalopathy (HP:0006846). Evidence: TAS. Frequency: Obligate (HP:0040280). (ORPHA:83601)
- Hashimoto thyroiditis (HP:0000872): A chronic, autoimmune type of thyroiditis associated with hypothyroidism. Evidence: TAS. Frequency: Very frequent (HP:0040281). (ORPHA:83601)
These phenotypes are associated with the disease Steroid-responsive encephalopathy associated with autoimmune thyroiditis (ORPHA:83601).
The following phenotypes are NOT associated with this disease:
- Cerebral edema (HP:0002181): Abnormal accumulation of fluid in the brain. Evidence: TAS. (ORPHA:83601)